Phenotypes associated with the disease Arterial tortuosity syndrome (ORPHA:3342):
- Congestive heart failure (HP:0001635): The presence of an abnormality of cardiac function that is responsible for the failure of the heart to pump blood at a rate that is commensurate with the needs of the tissues or a state in which abnormally elevated filling pressures are required for the heart to do so. Heart failure is frequently related to a defect in myocardial contraction. Evidence: TAS. Frequency: Very frequent (HP:0040281). (ORPHA:3342)
- Aortic root aneurysm (HP:0002616): An abnormal localized widening (dilatation) of the aortic root. Evidence: TAS. Frequency: Very frequent (HP:0040281). (ORPHA:3342)
- Vascular dilatation (HP:0002617): An abnormal increase in the diameter of an artery or vein, either as a diffuse dilatation or as a localized, sac-like outpouching of the vessel wall (aneurysm). Evidence: TAS. Frequency: Very frequent (HP:0040281). (ORPHA:3342)
- Aortic aneurysm (HP:0004942): Aortic dilatation refers to a dimension that is greater than the 95th percentile for the normal person age, sex and body size. In contrast, an aneurysm is defined as a localized dilation of the aorta that is more than 150 percent of predicted (ratio of observed to expected diameter 1.5 or more). Aneurysm should be distinguished from ectasia, which represents a diffuse dilation of the aorta less than 50 percent of normal aorta diameter. Evidence: TAS. Frequency: Very frequent (HP:0040281). (ORPHA:3342)
- Abnormal carotid artery morphology (HP:0005344): Any structural abnormality of the carotid arteries, including the common carotid artery and its' arterial branches. Evidence: TAS. Frequency: Very frequent (HP:0040281). (ORPHA:3342)
- Arterial stenosis (HP:0100545): Narrowing or constriction of the inner surface (lumen) of an artery. Evidence: TAS. Frequency: Very frequent (HP:0040281). (ORPHA:3342)
- Telangiectasia of the skin (HP:0100585): Presence of small, permanently dilated blood vessels near the surface of the skin, visible as small focal red lesions. Evidence: TAS. Frequency: Very frequent (HP:0040281). (ORPHA:3342)
- Inguinal hernia (HP:0000023): Protrusion of the contents of the abdominal cavity through the inguinal canal. Evidence: TAS. Frequency: Frequent (HP:0040282). (ORPHA:3342)
- Long face (HP:0000276): Facial height (length) is more than 2 standard deviations above the mean (objective); or, an apparent increase in the height (length) of the face (subjective). Evidence: TAS. Frequency: Frequent (HP:0040282). (ORPHA:3342)
- Hypertelorism (HP:0000316): Interpupillary distance more than 2 SD above the mean (alternatively, the appearance of an increased interpupillary distance or widely spaced eyes). Evidence: TAS. Frequency: Frequent (HP:0040282). (ORPHA:3342)
- Macrotia (HP:0000400): Median longitudinal ear length greater than two standard deviations above the mean and median ear width greater than two standard deviations above the mean (objective); or, apparent increase in length and width of the pinna (subjective). Evidence: TAS. Frequency: Frequent (HP:0040282). (ORPHA:3342)
- Thin skin (HP:0000963): Reduction in thickness of the skin, generally associated with a loss of suppleness and elasticity of the skin. Evidence: TAS. Frequency: Frequent (HP:0040282). (ORPHA:3342)
- Hyperextensible skin (HP:0000974): A condition in which the skin can be stretched beyond normal, and then returns to its initial position. Evidence: TAS. Frequency: Frequent (HP:0040282). (ORPHA:3342)
- Craniosynostosis (HP:0001363): Craniosynostosis refers to the premature closure of the cranial sutures. Primary craniosynostosis refers to the closure of one or more sutures due to abnormalities in skull development, and secondary craniosynostosis results from failure of brain growth. Evidence: TAS. Frequency: Frequent (HP:0040282). (ORPHA:3342)
- Aortic dissection (HP:0002647): Aortic dissection refers to a tear in the intimal layer of the aorta causing a separation between the intima and the medial layers of the aorta. Evidence: TAS. Frequency: Frequent (HP:0040282). (ORPHA:3342)
- Pulmonary artery stenosis (HP:0004415): An abnormal narrowing or constriction of the pulmonary artery, in the main pulmonary artery and/or in the left or right pulmonary artery branches. Evidence: TAS. Frequency: Frequent (HP:0040282). (ORPHA:3342)
- Abnormal zygomatic bone morphology (HP:0010668): An abnormality of the zygomatic bone. Evidence: TAS. Frequency: Frequent (HP:0040282). (ORPHA:3342)
- Fatigue (HP:0012378): A subjective feeling of tiredness characterized by a lack of energy and motivation. Evidence: TAS. Frequency: Frequent (HP:0040282). (ORPHA:3342)
- Femoral hernia (HP:0100541): A hernia which occurs just below the inguinal ligament, where abdominal contents pass through a naturally occurring weakness called the femoral canal. Evidence: TAS. Frequency: Frequent (HP:0040282). (ORPHA:3342)
- Macrocephaly (HP:0000256): Occipitofrontal (head) circumference greater than 97th centile compared to appropriate, age matched, sex-matched normal standards. Alternatively, a apparently increased size of the cranium. Evidence: TAS. Frequency: Occasional (HP:0040283). (ORPHA:3342)
- Malar flattening (HP:0000272): Underdevelopment of the malar prominence of the jugal bone (zygomatic bone in mammals), appreciated in profile, frontal view, and/or by palpation. Evidence: TAS. Frequency: Occasional (HP:0040283). (ORPHA:3342)
- Strabismus (HP:0000486): A misalignment of the eyes so that the visual axes deviate from bifoveal fixation. The classification of strabismus may be based on a number of features including the relative position of the eyes, whether the deviation is latent or manifest, intermittent or constant, concomitant or otherwise and according to the age of onset and the relevance of any associated refractive error. Evidence: TAS. Frequency: Occasional (HP:0040283). (ORPHA:3342)
- Myopia (HP:0000545): An abnormality of refraction characterized by the ability to see objects nearby clearly, while objects in the distance appear blurry. Evidence: TAS. Frequency: Occasional (HP:0040283). (ORPHA:3342)
- Keratoconus (HP:0000563): A cone-shaped deformity of the cornea characterized by the presence of corneal distortion secondary to thinning of the apex. Evidence: TAS. Frequency: Occasional (HP:0040283). (ORPHA:3342)
- Blepharophimosis (HP:0000581): A fixed reduction in the vertical distance between the upper and lower eyelids with short palpebral fissures. Evidence: TAS. Frequency: Occasional (HP:0040283). (ORPHA:3342)
- Hypertension (HP:0000822): The presence of chronic increased pressure in the systemic arterial system. Evidence: TAS. Frequency: Occasional (HP:0040283). (ORPHA:3342)
- Keratoglobus (HP:0001119): Limbus-to-limbus corneal thinning, often greatest in the periphery, with globular protrusion of the cornea. Evidence: TAS. Frequency: Occasional (HP:0040283). (ORPHA:3342)
- Arachnodactyly (HP:0001166): Abnormally long and slender fingers (spider fingers). Evidence: TAS. Frequency: Occasional (HP:0040283). (ORPHA:3342)
- Intellectual disability (HP:0001249): The term intellectual disability or intellectual developmental disorder is used to describe significantly sub-average intellectual and adaptive functioning based on clinical assessment and as measured by individually administered, appropriately normed, standardized and validated tests of intellectual functioning and adaptive behavior, with onset during the developmental period from infancy through adolescence. Evidence: TAS. Frequency: Occasional (HP:0040283). (ORPHA:3342)
- Hypotonia (HP:0001252): Hypotonia is an abnormally low muscle tone (the amount of tension or resistance to movement in a muscle). Even when relaxed, muscles have a continuous and passive partial contraction which provides some resistance to passive stretching. Hypotonia thus manifests as diminished resistance to passive stretching. Hypotonia is not the same as muscle weakness, although the two conditions can co-exist. Evidence: TAS. Frequency: Occasional (HP:0040283). (ORPHA:3342)
- Global developmental delay (HP:0001263): A delay in the achievement of motor or mental milestones in the domains of development of a child, including motor skills, speech and language, cognitive skills, and social and emotional skills. This term should only be used to describe children younger than five years of age. Evidence: TAS. Frequency: Occasional (HP:0040283). (ORPHA:3342)
- Specific learning disability (HP:0001328): Impairment of certain skills such as reading or writing, coordination, self-control, or attention that interfere with the ability to learn. The impairment is not related to a global deficiency of intelligence. Evidence: TAS. Frequency: Occasional (HP:0040283). (ORPHA:3342)
- Hip dysplasia (HP:0001385): The presence of developmental dysplasia of the hip. Evidence: TAS. Frequency: Occasional (HP:0040283). (ORPHA:3342)
- Redundant skin (HP:0001582): Loose and sagging skin often associated with loss of skin elasticity. Evidence: TAS. Frequency: Occasional (HP:0040283). (ORPHA:3342)
- Abnormal myocardium morphology (HP:0001637): A structural anomaly of the muscle layer of the heart wall. Evidence: TAS. Frequency: Occasional (HP:0040283). (ORPHA:3342)
- Hypertrophic cardiomyopathy (HP:0001639): Hypertrophic cardiomyopathy (HCM) is defined by the presence of increased ventricular wall thickness or mass in the absence of loading conditions (hypertension, valve disease) sufficient to cause the observed abnormality. Evidence: TAS. Frequency: Occasional (HP:0040283). (ORPHA:3342)
- Dilated cardiomyopathy (HP:0001644): Dilated cardiomyopathy (DCM) is defined by the presence of left ventricular dilatation and left ventricular systolic dysfunction in the absence of abnormal loading conditions (hypertension, valve disease) or coronary artery disease sufficient to cause global systolic impairment. Right ventricular dilation and dysfunction may be present but are not necessary for the diagnosis. Evidence: TAS. Frequency: Occasional (HP:0040283). (ORPHA:3342)
- Myocardial infarction (HP:0001658): Necrosis of the myocardium caused by an obstruction of the blood supply to the heart and often associated with chest pain, shortness of breath, palpitations, and anxiety as well as characteristic EKG findings and elevation of serum markers including creatine kinase-MB fraction and troponin. Evidence: TAS. Frequency: Occasional (HP:0040283). (ORPHA:3342)
- Cardiac arrest (HP:0001695): An abrupt loss of heart function. Evidence: TAS. Frequency: Occasional (HP:0040283). (ORPHA:3342)
- Rocker bottom foot (HP:0001838): The presence of both a prominent heel and a convex contour of the sole. Evidence: TAS. Frequency: Occasional (HP:0040283). (ORPHA:3342)
- Gastroesophageal reflux (HP:0002020): A condition in which the stomach contents leak backwards from the stomach into the esophagus through the lower esophageal sphincter. Evidence: TAS. Frequency: Occasional (HP:0040283). (ORPHA:3342)
- Pyloric stenosis (HP:0002021): Pyloric stenosis, also known as infantile hypertrophic pyloric stenosis, is an uncommon condition in infants characterized by abnormal thickening of the pylorus muscles in the stomach leading to gastric outlet obstruction. Clinically infants are well at birth. Then, at 3 to 6 weeks of age, the infants present with projectile vomiting, potentially leading to dehydration and weight loss. Evidence: TAS. Frequency: Occasional (HP:0040283). (ORPHA:3342)
- Hiatus hernia (HP:0002036): The presence of a hernia in which the upper part of the stomach, i.e., mainly the gastric cardia protrudes through the diaphragmatic esophageal hiatus. Evidence: TAS. Frequency: Occasional (HP:0040283). (ORPHA:3342)
- Dyspnea (HP:0002094): Difficult or labored breathing. Dyspnea is a subjective feeling only the patient can rate, e.g., on a Borg scale. Evidence: TAS. Frequency: Occasional (HP:0040283). (ORPHA:3342)
- Respiratory distress (HP:0002098): Respiratory distress is objectively observable as the physical or emotional consequences from the experience of dyspnea. The physical presentation of respiratory distress is generally referred to as labored breathing, while the sensation of respiratory distress is called shortness of breath or dyspnea. Evidence: TAS. Frequency: Occasional (HP:0040283). (ORPHA:3342)
- Scoliosis (HP:0002650): The presence of an abnormal lateral curvature of the spine. Evidence: TAS. Frequency: Occasional (HP:0040283). (ORPHA:3342)
- Coxa valga (HP:0002673): Coxa valga is a deformity of the hip in which the angle between the femoral shaft and the femoral neck is increased compared to age-adjusted values (about 150 degrees in newborns gradually reducing to 120-130 degrees in adults). Evidence: TAS. Frequency: Occasional (HP:0040283). (ORPHA:3342)
- Coxa vara (HP:0002812): Coxa vara includes all forms of decrease of the femoral neck shaft angle (the angle between the neck and the shaft of the femur) to less than 120 degrees. Evidence: TAS. Frequency: Occasional (HP:0040283). (ORPHA:3342)
- Hip dislocation (HP:0002827): Displacement of the femur from its normal location in the hip joint. Evidence: TAS. Frequency: Occasional (HP:0040283). (ORPHA:3342)
- Respiratory failure (HP:0002878): A severe form of respiratory insufficiency characterized by inadequate gas exchange such that the levels of oxygen or carbon dioxide cannot be maintained within normal limits. Evidence: TAS. Frequency: Occasional (HP:0040283). (ORPHA:3342)
- Short nose (HP:0003196): Distance from nasion to subnasale more than two standard deviations below the mean, or alternatively, an apparently decreased length from the nasal root to the nasal tip. Evidence: TAS. Frequency: Occasional (HP:0040283). (ORPHA:3342)
- Clinodactyly of the 5th finger (HP:0004209): Clinodactyly refers to a bending or curvature of the fifth finger in the radial direction (i.e., towards the 4th finger). Evidence: TAS. Frequency: Occasional (HP:0040283). (ORPHA:3342)
- Avascular necrosis of the capital femoral epiphysis (HP:0005743): Avascular necrosis of the proximal epiphysis of the femur occurring in growing children and caused by an interruption of the blood supply to the head of the femur close to the hip joint. The necrosis is characteristically associated with flattening of the femoral head, for which reason the term coxa plana has been used to refer to this feature in the medical literature. Evidence: TAS. Frequency: Occasional (HP:0040283). (ORPHA:3342)
- Cardiorespiratory arrest (HP:0006543). Evidence: TAS. Frequency: Occasional (HP:0040283). (ORPHA:3342)
- Prematurely aged appearance (HP:0007495). Evidence: TAS. Frequency: Occasional (HP:0040283). (ORPHA:3342)
- Long palm (HP:0011302): For children from birth to 16 years of age the length of the palm is more than the 97th centile; or, the length of the palm appears relatively long compared to the finger length or the limb length. Evidence: TAS. Frequency: Occasional (HP:0040283). (ORPHA:3342)
- Short palpebral fissure (HP:0012745): Distance between the medial and lateral canthi is more than 2 SD below the mean for age (objective); or, apparently reduced length of the palpebral fissures. Evidence: TAS. Frequency: Occasional (HP:0040283). (ORPHA:3342)
- Myocarditis (HP:0012819): Inflammation of the myocardium. Evidence: TAS. Frequency: Occasional (HP:0040283). (ORPHA:3342)
- Esophagitis (HP:0100633): Inflammation of the esophagus. Evidence: TAS. Frequency: Occasional (HP:0040283). (ORPHA:3342)
- Joint hypermobility (HP:0001382): The capability that a joint (or a group of joints) has to move, passively and/or actively, beyond normal limits along physiological axes. Evidence: TAS. Frequency: Frequent (HP:0040282). (ORPHA:3342)
- Median cleft palate (HP:0009099): Cleft palate of the midline of the palate. Evidence: TAS. Frequency: Frequent (HP:0040282). (ORPHA:3342)